Phenotypes associated with the disease dacryocystitis-osteopoikilosis syndrome (OMIM:166705):
- Osteopoikilosis (HP:0010739): Osteopoikilosis is a benign, asymptomatic sclerotic dysplasia of the bones. It affects both male and female and may be seen at any age. Radiographically sclerotic circular or ovoid lesions are usually symmetrically distributed in a periarticular location. Lesions can increase or decrease in size and number in serial radiographs or even disappear and do not have increased bone radiotracer uptake. Evidence: IEA. (OMIM:166705)
- Dacryocystitis (HP:0000620): Inflammation of the nasolacrimal sac. Evidence: IEA. (OMIM:166705)
- Autosomal dominant inheritance (HP:0000006): A mode of inheritance that is observed for traits related to a gene encoded on one of the autosomes (i.e., the human chromosomes 1-22) in which a trait manifests in heterozygotes. In the context of medical genetics, an autosomal dominant disorder is caused when a single copy of the mutant allele is present. Males and females are affected equally, and can both transmit the disorder with a risk of 50% for each child of inheriting the mutant allele. Evidence: IEA. (OMIM:166705)